- Elevated circulating aspartate aminotransferase concentration (HP:0031956): The concentration of aspartate aminotransferase (AST) in the blood circulation is above the upper limit of normal. Evidence: PCS. Frequency: 1/2. (PMID:23315540)
- Hypertrophic cardiomyopathy (HP:0001639): Hypertrophic cardiomyopathy (HCM) is defined by the presence of increased ventricular wall thickness or mass in the absence of loading conditions (hypertension, valve disease) sufficient to cause the observed abnormality. Evidence: PCS. Frequency: 2/2. (PMID:23315540)
- Increased circulating lactate concentration (HP:0002151): Abnormally increased level of blood lactate (2-hydroxypropanoic acid). Lactate is produced from pyruvate by lactate dehydrogenase during normal metabolism. The terms lactate and lactic acid are often used interchangeably but lactate (the component measured in blood) is strictly a weak base whereas lactic acid is the corresponding acid. Lactic acidosis is often used clinically to describe elevated lactate but should be reserved for cases where there is a corresponding acidosis (pH below 7.35). Evidence: PCS. Frequency: 1/2. (PMID:23315540)
- Infantile onset (HP:0003593): Onset of signs or symptoms of disease between 28 days to one year of life. Evidence: PCS. Frequency: 2/2. (PMID:23315540)
- Autosomal recessive inheritance (HP:0000007): A mode of inheritance that is observed for traits related to a gene encoded on one of the autosomes (i.e., the human chromosomes 1-22) in which a trait manifests in individuals with two pathogenic alleles, either homozygotes (two copies of the same mutant allele) or compound heterozygotes (whereby each copy of a gene has a distinct mutant allele). Evidence: PCS. (PMID:23315540)
- Death in infancy (HP:0001522): Death within the first 24 months of life. Evidence: PCS. Frequency: 1/2. (PMID:23315540)
- Microvesicular hepatic steatosis (HP:0001414): A form of hepatic steatosis characterized by the presence of small, lipid-laden vesicles in the affected hepatocytes. Evidence: PCS. Frequency: 2/2. (PMID:23315540)
- Elevated circulating alanine aminotransferase concentration (HP:0031964): An abnormally high concentration in the circulation of alanine aminotransferase (ALT). Evidence: PCS. Frequency: 1/2. (PMID:23315540)
- Cytochrome C oxidase-negative muscle fibers (HP:0003688): An abnormally reduced activity of the enzyme cytochrome C oxidase in muscle tissue. Evidence: PCS. Frequency: 1/2. (PMID:23315540)
These phenotypes are associated with the disease infantile hypertrophic cardiomyopathy due to MRPL44 deficiency (OMIM:615395).